- Vertigo (HP:0002321, a Human Phenotype Ontology term): An abnormal sensation of spinning while the body is actually stationary. Evidence: TAS. (OMIM:609289)
- Syncope (HP:0001279, a Human Phenotype Ontology term): A transient loss of consciousness (i.e., characterized by a rapid onset, a short duration, and a spontaneous and complete recovery) due to cerebral hypoperfusion. Evidence: IEA. (OMIM:609289)
- Autosomal dominant inheritance (HP:0000006, a Human Phenotype Ontology term): A mode of inheritance that is observed for traits related to a gene encoded on one of the autosomes (i.e., the human chromosomes 1-22) in which a trait manifests in heterozygotes. In the context of medical genetics, an autosomal dominant disorder is caused when a single copy of the mutant allele is present. Males and females are affected equally, and can both transmit the disorder with a risk of 50% for each child of inheriting the mutant allele. Evidence: TAS. (OMIM:609289)
These phenotypes are associated with the disease syncope, familial vasovagal (OMIM:609289, an entry in Online Mendelian Inheritance in Man).